Phenotypes associated with the disease Alcohol sensitivity, acute (OMIM:100650):
- Reduced acetaldehyde dehydrogenase level (HP:0003533): Decreased level of acetaldehyde dehydrogenase (ALDH). ALDH and alcohol dehydrogenase (ADH) are the primary enzymes involved in alcohol metabolism. Evidence: TAS. (OMIM:100650)
- Facial flushing after alcohol intake (HP:0001033). Evidence: TAS. (OMIM:100650)
- Autosomal dominant inheritance (HP:0000006): A mode of inheritance that is observed for traits related to a gene encoded on one of the autosomes (i.e., the human chromosomes 1-22) in which a trait manifests in heterozygotes. In the context of medical genetics, an autosomal dominant disorder is caused when a single copy of the mutant allele is present. Males and females are affected equally, and can both transmit the disorder with a risk of 50% for each child of inheriting the mutant allele. Evidence: TAS. (OMIM:100650)